- Abnormality of metabolism/homeostasis (HP:0001939). Evidence: IEA. (OMIM:276200)
- Autosomal recessive inheritance (HP:0000007): A mode of inheritance that is observed for traits related to a gene encoded on one of the autosomes (i.e., the human chromosomes 1-22) in which a trait manifests in individuals with two pathogenic alleles, either homozygotes (two copies of the same mutant allele) or compound heterozygotes (whereby each copy of a gene has a distinct mutant allele). Evidence: TAS. (OMIM:276200)
- Growth delay (HP:0001510): A deficiency or slowing down of growth pre- and postnatally. Evidence: IEA. (OMIM:276200)
- Intellectual disability (HP:0001249): The term intellectual disability or intellectual developmental disorder is used to describe significantly sub-average intellectual and adaptive functioning based on clinical assessment and as measured by individually administered, appropriately normed, standardized and validated tests of intellectual functioning and adaptive behavior, with onset during the developmental period from infancy through adolescence. Evidence: IEA. (OMIM:276200)
These phenotypes are associated with the disease T-substance anomaly (OMIM:276200).